- Urinary retention (HP:0000016): Inability to completely empty the urinary bladder during the process of urination. Evidence: TAS. Frequency: Frequent (HP:0040282). (ORPHA:178475)
- Ptosis (HP:0000508): The upper eyelid margin is positioned 3 mm or more lower than usual and covers the superior portion of the iris (objective); or, the upper lid margin obscures at least part of the pupil (subjective). Evidence: TAS. Frequency: Very frequent (HP:0040281). (ORPHA:178475)
- Diplopia (HP:0000651): Diplopia is a condition in which a single object is perceived as two images, it is also known as double vision. Evidence: TAS. Frequency: Very frequent (HP:0040281). (ORPHA:178475)
- Dysarthria (HP:0001260): Dysarthric speech is a general description referring to a neurological speech disorder characterized by poor articulation. Depending on the involved neurological structures, dysarthria may be further classified as spastic, flaccid, ataxic, hyperkinetic and hypokinetic, or mixed. Evidence: TAS. Frequency: Very frequent (HP:0040281). (ORPHA:178475)
- Muscle weakness (HP:0001324): Reduced strength of muscles. Evidence: TAS. Frequency: Very frequent (HP:0040281). (ORPHA:178475)
- Cardiac arrest (HP:0001695): An abrupt loss of heart function. Evidence: TAS. Frequency: Occasional (HP:0040283). (ORPHA:178475)
- Fever (HP:0001945): Body temperature elevated above the normal range. Evidence: TAS. Frequency: Occasional (HP:0040283). (ORPHA:178475)
- Dysphagia (HP:0002015): Difficulty in swallowing. Evidence: TAS. Frequency: Very frequent (HP:0040281). (ORPHA:178475)
- Constipation (HP:0002019): Infrequent or difficult evacuation of feces. Evidence: TAS. Frequency: Very frequent (HP:0040281). (ORPHA:178475)
- Dyspnea (HP:0002094): Difficult or labored breathing. Dyspnea is a subjective feeling only the patient can rate, e.g., on a Borg scale. Evidence: TAS. Frequency: Frequent (HP:0040282). (ORPHA:178475)
- Respiratory insufficiency due to muscle weakness (HP:0002747). Evidence: TAS. Frequency: Frequent (HP:0040282). (ORPHA:178475)
- Diaphragmatic paralysis (HP:0006597): The presence of a paralyzed diaphragm. Evidence: TAS. Frequency: Very frequent (HP:0040281). (ORPHA:178475)
- Cranial nerve paralysis (HP:0006824). Evidence: TAS. Frequency: Very frequent (HP:0040281). (ORPHA:178475)
- Mydriasis (HP:0011499): Abnormal dilatation of the iris. Evidence: TAS. Frequency: Very frequent (HP:0040281). (ORPHA:178475)
- Cerebral palsy (HP:0100021): Cerebral palsy describes a group of permanent disorders of the development of movement and posture, causing activity limitation, that are attributed to nonprogressive disturbances that occurred in the developing fetal or infant brain. The motor disorders of cerebral palsy are often accompanied by disturbances of sensation, perception, cognition, communication, and behavior, by epilepsy, and by secondary musculoskeletal problems. Evidence: TAS. Frequency: Very frequent (HP:0040281). (ORPHA:178475)
These phenotypes are associated with the disease Wound botulism (ORPHA:178475).